- Congenital onset (HP:0003577): A phenotypic abnormality that is present at birth. Evidence: PCS. Frequency: 1/1. (PMID:26880018)
- Retinal pigment epithelial mottling (HP:0007814): Mottling (spots or blotches of different shades) of the retinal pigment epithelium, i.e., localized or generalized fundus pigment granularity associated with processes at the level of the retinal pigment epithelium. Evidence: PCS. Frequency: 1/1. (PMID:26880018)
- Brachydactyly (HP:0001156): Digits that appear disproportionately short compared to the hand/foot. The word brachydactyly is used here to describe a series distinct patterns of shortened digits (brachydactyly types A-E). This is the sense used here. Evidence: PCS. Frequency: 1/1. (PMID:26880018)
- Hypermetropia (HP:0000540): An abnormality of refraction characterized by the ability to see objects in the distance clearly, while objects nearby appear blurry. Evidence: PCS. Frequency: 1/1. (PMID:26880018)
- Short stature (HP:0004322): A height below that which is expected according to age and gender norms. Although there is no universally accepted definition of short stature, many refer to "short stature" as height more than 2 standard deviations below the mean for age and gender (or below the 3rd percentile for age and gender dependent norms). Evidence: TAS. (OMIM:617102)
- Short metacarpal (HP:0010049): Diminished length of one or more metacarpal bones in relation to the others of the same hand or to the contralateral metacarpal. Evidence: PCS. Frequency: 1/1. (PMID:26880018)
- Motor delay (HP:0001270): A type of Developmental delay characterized by a delay in acquiring motor skills. Evidence: PCS. Frequency: 1/1. (PMID:26880018)
- Short thorax (HP:0010306): Reduced inferior to superior extent of the thorax. Evidence: PCS. Frequency: 1/1. (PMID:26880018)
- Short metatarsal (HP:0010743): Diminished length of a metatarsal bone, with resultant proximal displacement of the associated toe. Evidence: PCS. Frequency: 1/1. (PMID:26880018)
- Nystagmus (HP:0000639): Rhythmic, involuntary oscillations of one or both eyes related to abnormality in fixation, conjugate gaze, or vestibular mechanisms. Evidence: PCS. Frequency: 1/1. (PMID:26880018)
- Cone-shaped epiphyses of the phalanges of the hand (HP:0010230): A cone-shaped appearance of the epiphyses of the fingers of the hand, producing a 'ball-in-a-socket' appearance. The related entity 'angel-shaped' epiphysis refers to a pronounced cone-shaped epiphysis in combination with a pseudoepiphysis at the distal end of a phalanx. Evidence: PCS. Frequency: 1/1. (PMID:26880018)
- Thick vermilion border (HP:0012471): Increased width of the skin of vermilion border region of upper lip. Evidence: PCS. Frequency: 1/1. (PMID:26880018)
- Short distal phalanx of finger (HP:0009882): Short distance from the end of the finger to the most distal interphalangeal crease or the distal interphalangeal joint flexion point. That is, hypoplasia of one or more of the distal phalanx of finger. Evidence: PCS. Frequency: 1/1. (PMID:26880018)
- Narrow chest (HP:0000774): Reduced width of the chest from side to side, associated with a reduced distance from the sternal notch to the tip of the shoulder. Evidence: PCS. Frequency: 1/1. (PMID:26880018)
- Short phalanx of finger (HP:0009803): Short (hypoplastic) phalanx of finger, affecting one or more phalanges. Evidence: PCS. Frequency: 1/1. (PMID:26880018)
- Carious teeth (HP:0000670): Caries is a multifactorial bacterial infection affecting the structure of the tooth. This term has been used to describe the presence of more than expected dental caries. Evidence: PCS. Frequency: 1/1. (PMID:26880018)
- Limb undergrowth (HP:0009826): Limb shortening because of underdevelopment of one or more bones of the extremities. Evidence: PCS. Frequency: 1/1. (PMID:26880018)
- Wide nasal bridge (HP:0000431): Increased breadth of the nasal bridge (and with it, the nasal root). Evidence: PCS. Frequency: 1/1. (PMID:26880018)
- Hypoplasia of the corpus callosum (HP:0002079): Underdevelopment of the corpus callosum. Evidence: PCS. Frequency: 1/1. (PMID:26880018)
- Full cheeks (HP:0000293): Increased prominence or roundness of soft tissues between zygomata and mandible. Evidence: PCS. Frequency: 1/1. (PMID:26880018)
- Respiratory distress (HP:0002098): Respiratory distress is objectively observable as the physical or emotional consequences from the experience of dyspnea. The physical presentation of respiratory distress is generally referred to as labored breathing, while the sensation of respiratory distress is called shortness of breath or dyspnea. Evidence: PCS. Frequency: 1/1. (PMID:26880018)
- Midface retrusion (HP:0011800): Posterior positions and/or vertical shortening of the infraorbital and perialar regions, or increased concavity of the face and/or reduced nasolabial angle. Evidence: PCS. Frequency: 1/1. (PMID:26880018)
- Depressed nasal bridge (HP:0005280): Posterior positioning of the nasal root in relation to the overall facial profile for age. Evidence: PCS. Frequency: 1/1. (PMID:26880018)
- Flat acetabular roof (HP:0003180): Flattening of the superior part of the acetabulum, which is a cup-shaped cavity at the base of the hipbone into which the ball-shaped head of the femur fits. The acetabular roof thereby appears horizontal rather than arched, as it normally does. Evidence: TAS. (OMIM:617102)
- Postaxial polydactyly (HP:0100259): A form of polydactyly in which the extra digit or digits are localized on the side of the fifth finger or fifth toe. Evidence: PCS. Frequency: 1/1. Onset: Congenital onset (HP:0003577). (PMID:26880018)
- Telecanthus (HP:0000506): Distance between the inner canthi more than two standard deviations above the mean (objective); or, apparently increased distance between the inner canthi. Evidence: PCS. Frequency: 1/1. (PMID:26880018)
- Angel-shaped phalanx (HP:0032078): A phalangeal malformation that is termed angel-shaped phalanx (ASP), because of its resemblance to the angels used for decoration of Christmas trees. The various components of an angel-shaped phalanx are: diaphyseal cuff (wings), surrounding a meta-diaphyseal core (body), which may appear empty or structured with a cone-shaped epiphysis (skirt) and pseudoepiphysis (head). Evidence: PCS. Frequency: 1/1. (PMID:26880018)
- Autosomal recessive inheritance (HP:0000007): A mode of inheritance that is observed for traits related to a gene encoded on one of the autosomes (i.e., the human chromosomes 1-22) in which a trait manifests in individuals with two pathogenic alleles, either homozygotes (two copies of the same mutant allele) or compound heterozygotes (whereby each copy of a gene has a distinct mutant allele). Evidence: PCS. (PMID:26880018)
- High forehead (HP:0000348): An abnormally increased height of the forehead. Evidence: PCS. Frequency: 1/1. (PMID:26880018)
- Protuberant abdomen (HP:0001538): A thrusting or bulging out of the abdomen. Evidence: PCS. Frequency: 1/1. (PMID:26880018)
- Dolichocephaly (HP:0000268): An abnormality of skull shape characterized by a increased anterior-posterior diameter, i.e., an increased antero-posterior dimension of the skull. Cephalic index less than 76%. Alternatively, an apparently increased antero-posterior length of the head compared to width. Often due to premature closure of the sagittal suture. Evidence: PCS. Frequency: 1/1. (PMID:26880018)
- Sandal gap (HP:0001852): A widely spaced gap between the first toe (the great toe) and the second toe. Evidence: TAS. (OMIM:617102)
- Low-set ears (HP:0000369): Upper insertion of the ear to the scalp below an imaginary horizontal line drawn between the inner canthi of the eye and extending posteriorly to the ear. Evidence: PCS. Frequency: 1/1. (PMID:26880018)
- Widely spaced teeth (HP:0000687): Increased spaces (diastemata) between most of the teeth in the same dental arch. Evidence: PCS. Frequency: 1/1. (PMID:26880018)
These phenotypes are associated with the disease short-rib thoracic dysplasia 16 with or without polydactyly (OMIM:617102).